- Facial edema (HP:0000282, a Human Phenotype Ontology term). Evidence: TAS. Frequency: Very frequent (HP:0040281, a Human Phenotype Ontology term). (ORPHA:319213)
- Thrombocytopenia (HP:0001873, a Human Phenotype Ontology term): A reduction in the number of circulating thrombocytes. Evidence: TAS. Frequency: Very frequent (HP:0040281, a Human Phenotype Ontology term). (ORPHA:319213)
- Fever (HP:0001945, a Human Phenotype Ontology term): Body temperature elevated above the normal range. Evidence: TAS. Frequency: Very frequent (HP:0040281, a Human Phenotype Ontology term). (ORPHA:319213)
- Diarrhea (HP:0002014, a Human Phenotype Ontology term): Abnormally increased frequency (usually defined as three or more) loose or watery bowel movements a day. Evidence: TAS. Frequency: Very frequent (HP:0040281, a Human Phenotype Ontology term). (ORPHA:319213)
- Headache (HP:0002315, a Human Phenotype Ontology term): Cephalgia, or pain sensed in various parts of the head, not confined to the area of distribution of any nerve. Evidence: TAS. Frequency: Very frequent (HP:0040281, a Human Phenotype Ontology term). (ORPHA:319213)
- Elevated circulating hepatic transaminase concentration (HP:0002910, a Human Phenotype Ontology term): Elevations of the levels of SGOT and SGPT in the serum. SGOT (serum glutamic oxaloacetic transaminase) and SGPT (serum glutamic pyruvic transaminase) are transaminases primarily found in the liver and heart and are released into the bloodstream as the result of liver or heart damage. SGOT and SGPT are used clinically mainly as markers of liver damage. Evidence: TAS. Frequency: Very frequent (HP:0040281, a Human Phenotype Ontology term). (ORPHA:319213)
- Myalgia (HP:0003326, a Human Phenotype Ontology term): Pain in muscle. Evidence: TAS. Frequency: Very frequent (HP:0040281, a Human Phenotype Ontology term). (ORPHA:319213)
- Stiff neck (HP:0025258, a Human Phenotype Ontology term): A sensation of tightness in the neck when attempting to move it, especially after a period of inactivity. Neck stiffness often involves soreness and difficulty moving the neck, especially when trying to turn the head to the side. Evidence: TAS. Frequency: Very frequent (HP:0040281, a Human Phenotype Ontology term). (ORPHA:319213)
- Pharyngitis (HP:0025439, a Human Phenotype Ontology term): Inflammation (due to infection or irritation) of the pharynx. Evidence: TAS. Frequency: Very frequent (HP:0040281, a Human Phenotype Ontology term). (ORPHA:319213)
- Severe viral infection (HP:0031691, a Human Phenotype Ontology term): An unusually severe viral infection. Evidence: TAS. Frequency: Very frequent (HP:0040281, a Human Phenotype Ontology term). (ORPHA:319213)
- Renal insufficiency (HP:0000083, a Human Phenotype Ontology term): A reduction in the level of performance of the kidneys in areas of function comprising the concentration of urine, removal of wastes, the maintenance of electrolyte balance, homeostasis of blood pressure, and calcium metabolism. Evidence: TAS. Frequency: Frequent (HP:0040282, a Human Phenotype Ontology term). (ORPHA:319213)
- Abnormality of the nervous system (HP:0000707, a Human Phenotype Ontology term): An abnormality of the nervous system. Evidence: TAS. Frequency: Frequent (HP:0040282, a Human Phenotype Ontology term). (ORPHA:319213)
- Skin rash (HP:0000988, a Human Phenotype Ontology term): A red eruption of the skin. Evidence: TAS. Frequency: Frequent (HP:0040282, a Human Phenotype Ontology term). (ORPHA:319213)
- Coma (HP:0001259, a Human Phenotype Ontology term): The complete absence of wakefulness and consciousness, which is evident through a lack of response to any form of external stimuli. Evidence: TAS. Frequency: Frequent (HP:0040282, a Human Phenotype Ontology term). (ORPHA:319213)
- Confusion (HP:0001289, a Human Phenotype Ontology term): Lack of clarity and coherence of thought, perception, understanding, or action. Evidence: TAS. Frequency: Frequent (HP:0040282, a Human Phenotype Ontology term). (ORPHA:319213)
- Decreased total leukocyte count (HP:0001882, a Human Phenotype Ontology term): An abnormal decreased number of leukocytes in the blood. Evidence: TAS. Frequency: Frequent (HP:0040282, a Human Phenotype Ontology term). (ORPHA:319213)
- Decreased total lymphocyte count (HP:0001888, a Human Phenotype Ontology term): A reduced number of lymphocytes in the blood. Evidence: TAS. Frequency: Frequent (HP:0040282, a Human Phenotype Ontology term). (ORPHA:319213)
- Metabolic acidosis (HP:0001942, a Human Phenotype Ontology term): Metabolic acidosis (MA) is characterized by a fall in blood pH due to a reduction of serum bicarbonate concentration. This can occur as a result of either the accumulation of acids (high anion gap MA) or the loss of bicarbonate from the gastrointestinal tract or the kidney (hyperchloremic MA). By definition, MA is not due to a respirary cause. Evidence: TAS. Frequency: Frequent (HP:0040282, a Human Phenotype Ontology term). (ORPHA:319213)
- Increased total leukocyte count (HP:0001974, a Human Phenotype Ontology term): An abnormal increase in the number of leukocytes in the blood. Evidence: TAS. Frequency: Frequent (HP:0040282, a Human Phenotype Ontology term). (ORPHA:319213)
- Vomiting (HP:0002013, a Human Phenotype Ontology term): Forceful ejection of the contents of the stomach through the mouth by means of a series of involuntary spasmic contractions. Evidence: TAS. Frequency: Frequent (HP:0040282, a Human Phenotype Ontology term). (ORPHA:319213)
- Nausea (HP:0002018, a Human Phenotype Ontology term): A sensation of unease in the stomach together with an urge to vomit. Evidence: TAS. Frequency: Frequent (HP:0040282, a Human Phenotype Ontology term). (ORPHA:319213)
- Microscopic hematuria (HP:0002907, a Human Phenotype Ontology term): Microscopic hematuria detected by dipstick or microscopic examination of the urine. Evidence: TAS. Frequency: Frequent (HP:0040282, a Human Phenotype Ontology term). (ORPHA:319213)
- Prolonged partial thromboplastin time (HP:0003645, a Human Phenotype Ontology term): Increased time to coagulation in the partial thromboplastin time (PTT) test, a measure of the intrinsic and common coagulation pathways. Phospholipid, and activator, and calcium are mixed into an anticoagulated plasma sample, and the time is measured until a thrombus forms. Evidence: TAS. Frequency: Frequent (HP:0040282, a Human Phenotype Ontology term). (ORPHA:319213)
- Generalized edema (HP:0007430, a Human Phenotype Ontology term): Generalized abnormal accumulation of fluid beneath the skin, or in one or more cavities of the body. Evidence: TAS. Frequency: Frequent (HP:0040282, a Human Phenotype Ontology term). (ORPHA:319213)
- Elevated circulating C-reactive protein concentration (HP:0011227, a Human Phenotype Ontology term): The concentration of C-reactive protein in the blood circulation is above the upper limit of normal. Evidence: TAS. Frequency: Frequent (HP:0040282, a Human Phenotype Ontology term). (ORPHA:319213)
- Subconjunctival hemorrhage (HP:0011896, a Human Phenotype Ontology term): Bleeding beneath the mucous membrane that lines the inner surface of the eyelid. Evidence: TAS. Frequency: Frequent (HP:0040282, a Human Phenotype Ontology term). (ORPHA:319213)
- Increased circulating lactate dehydrogenase concentration (HP:0025435, a Human Phenotype Ontology term): An elevated level of the enzyme lactate dehydrogenase in the blood circulation. Evidence: TAS. Frequency: Frequent (HP:0040282, a Human Phenotype Ontology term). (ORPHA:319213)
- Shock (HP:0031273, a Human Phenotype Ontology term): The state in which profound and widespread reduction of effective tissue perfusion leads first to reversible, and then if prolonged, to irreversible cellular injury. Evidence: TAS. Frequency: Frequent (HP:0040282, a Human Phenotype Ontology term). (ORPHA:319213)
- Ecchymosis (HP:0031364, a Human Phenotype Ontology term): A purpuric lesion that is larger than 1 cm in diameter. Evidence: TAS. Frequency: Frequent (HP:0040282, a Human Phenotype Ontology term). (ORPHA:319213)
- Maculopapular exanthema (HP:0040186, a Human Phenotype Ontology term): A skin rash that is characterized by diffuse cutaneous erythema with areas of skin elevation. It may evolve to vesicles or papules as part of a more severe clinical entity. Different degrees of angioedema with involvement of subcutaneous tissue may also appear. Evidence: TAS. Frequency: Frequent (HP:0040282, a Human Phenotype Ontology term). (ORPHA:319213)
- Oliguria (HP:0100520, a Human Phenotype Ontology term): Low output of urine, clinically classified as an output below 300-500ml/day. Evidence: TAS. Frequency: Frequent (HP:0040282, a Human Phenotype Ontology term). (ORPHA:319213)
- Chest pain (HP:0100749, a Human Phenotype Ontology term): An unpleasant sensation characterized by physical discomfort (such as pricking, throbbing, or aching) localized to the chest. Evidence: TAS. Frequency: Frequent (HP:0040282, a Human Phenotype Ontology term). (ORPHA:319213)
- Photophobia (HP:0000613, a Human Phenotype Ontology term): Excessive sensitivity to light with the sensation of discomfort or pain in the eyes due to exposure to bright light. Evidence: TAS. Frequency: Occasional (HP:0040283, a Human Phenotype Ontology term). (ORPHA:319213)
- Anxiety (HP:0000739, a Human Phenotype Ontology term): Intense feelings of nervousness, tension, or panic often arise in response to interpersonal stresses. There is worry about the negative effects of past unpleasant experiences and future negative possibilities. Individuals may feel fearful, apprehensive, or threatened by uncertainty, and they may also have fears of falling apart or losing control. Evidence: TAS. Frequency: Occasional (HP:0040283, a Human Phenotype Ontology term). (ORPHA:319213)
- Hyperhidrosis (HP:0000975, a Human Phenotype Ontology term): Abnormal excessive perspiration (sweating) despite the lack of appropriate stimuli like hot and humid weather. Evidence: TAS. Frequency: Occasional (HP:0040283, a Human Phenotype Ontology term). (ORPHA:319213)
- Purpura (HP:0000979, a Human Phenotype Ontology term): Purpura (from Latin: purpura, meaning purple) is the appearance of red or purple discolorations on the skin that do not blanch on applying pressure. They are caused by bleeding underneath the skin. This term refers to an abnormally increased susceptibility to developing purpura. Purpura are larger than petechiae. Evidence: TAS. Frequency: Occasional (HP:0040283, a Human Phenotype Ontology term). (ORPHA:319213)
- Seizure (HP:0001250, a Human Phenotype Ontology term): A seizure is an intermittent abnormality of nervous system physiology characterized by a transient occurrence of signs and/or symptoms due to abnormal excessive or synchronous neuronal activity in the brain. Evidence: TAS. Frequency: Occasional (HP:0040283, a Human Phenotype Ontology term). (ORPHA:319213)
- Mental deterioration (HP:0001268, a Human Phenotype Ontology term): Loss of previously present mental abilities, generally in adults. Evidence: TAS. Frequency: Occasional (HP:0040283, a Human Phenotype Ontology term). (ORPHA:319213)
- Muscle weakness (HP:0001324, a Human Phenotype Ontology term): Reduced strength of muscles. Evidence: TAS. Frequency: Occasional (HP:0040283, a Human Phenotype Ontology term). (ORPHA:319213)
- Bradycardia (HP:0001662, a Human Phenotype Ontology term): A slower than normal heart rate (in adults, slower than 60 beats per minute). Evidence: TAS. Frequency: Occasional (HP:0040283, a Human Phenotype Ontology term). (ORPHA:319213)
- Dysphagia (HP:0002015, a Human Phenotype Ontology term): Difficulty in swallowing. Evidence: TAS. Frequency: Occasional (HP:0040283, a Human Phenotype Ontology term). (ORPHA:319213)
- Bilateral tonic-clonic seizure (HP:0002069, a Human Phenotype Ontology term): A bilateral tonic-clonic seizure is a seizure defined by a tonic (bilateral increased tone, lasting seconds to minutes) and then a clonic (bilateral sustained rhythmic jerking) phase. Evidence: TAS. Frequency: Occasional (HP:0040283, a Human Phenotype Ontology term). (ORPHA:319213)
- Respiratory distress (HP:0002098, a Human Phenotype Ontology term): Respiratory distress is objectively observable as the physical or emotional consequences from the experience of dyspnea. The physical presentation of respiratory distress is generally referred to as labored breathing, while the sensation of respiratory distress is called shortness of breath or dyspnea. Evidence: TAS. Frequency: Occasional (HP:0040283, a Human Phenotype Ontology term). (ORPHA:319213)
- Cerebral edema (HP:0002181, a Human Phenotype Ontology term): Abnormal accumulation of fluid in the brain. Evidence: TAS. Frequency: Occasional (HP:0040283, a Human Phenotype Ontology term). (ORPHA:319213)
- Resting tremor (HP:0002322, a Human Phenotype Ontology term): A resting tremor occurs when muscles are at rest and becomes less noticeable or disappears when the affected muscles are moved. Resting tremors are often slow and coarse. Evidence: TAS. Frequency: Occasional (HP:0040283, a Human Phenotype Ontology term). (ORPHA:319213)
- Drowsiness (HP:0002329, a Human Phenotype Ontology term): Abnormal feeling of sleepiness or difficulty staying awake. Evidence: TAS. Frequency: Occasional (HP:0040283, a Human Phenotype Ontology term). (ORPHA:319213)
- Hypotension (HP:0002615, a Human Phenotype Ontology term): Low Blood Pressure, vascular hypotension. Evidence: TAS. Frequency: Occasional (HP:0040283, a Human Phenotype Ontology term). (ORPHA:319213)
- Fulminant hepatitis (HP:0004787, a Human Phenotype Ontology term): Acute hepatitis complicated by acute liver failure with hepatic encephalopathy occurring less than 8 weeks after the onset of jaundice. Evidence: TAS. Frequency: Occasional (HP:0040283, a Human Phenotype Ontology term). (ORPHA:319213)
- Peripheral neuropathy (HP:0009830, a Human Phenotype Ontology term): Peripheral neuropathy is a general term for any disorder of the peripheral nervous system. The main clinical features used to classify peripheral neuropathy are distribution, type (mainly demyelinating versus mainly axonal), duration, and course. Evidence: TAS. Frequency: Occasional (HP:0040283, a Human Phenotype Ontology term). (ORPHA:319213)
- Rhinitis (HP:0012384, a Human Phenotype Ontology term): Inflammation of the nasal mucosa with nasal congestion. Evidence: TAS. Frequency: Occasional (HP:0040283, a Human Phenotype Ontology term). (ORPHA:319213)
- Myocarditis (HP:0012819, a Human Phenotype Ontology term): Inflammation of the myocardium. Evidence: TAS. Frequency: Occasional (HP:0040283, a Human Phenotype Ontology term). (ORPHA:319213)
- Rigors (HP:0025145, a Human Phenotype Ontology term): Severe chills with violent shivering. A rigor is an episode of shaking or exaggerated shivering which can occur with a high fever. Evidence: TAS. Frequency: Occasional (HP:0040283, a Human Phenotype Ontology term). (ORPHA:319213)
- Excessive bleeding after a venipuncture (HP:0030139, a Human Phenotype Ontology term): An abnormal high amount of bleeding following the procedure of taking a blood sample. Evidence: TAS. Frequency: Occasional (HP:0040283, a Human Phenotype Ontology term). (ORPHA:319213)
- Crackles (HP:0030830, a Human Phenotype Ontology term): Crackles are discontinuous, explosive, and nonmusical adventitious lung sounds normally heard in inspiration and sometimes during expiration. Crackles are usually classified as fine and coarse crackles based on their duration, loudness, pitch, timing in the respiratory cycle, and relationship to coughing and changing body position. Evidence: TAS. Frequency: Occasional (HP:0040283, a Human Phenotype Ontology term). (ORPHA:319213)
- Nonproductive cough (HP:0031246, a Human Phenotype Ontology term): A cough that does not produce phlegm or mucus. Evidence: TAS. Frequency: Occasional (HP:0040283, a Human Phenotype Ontology term). (ORPHA:319213)
- Odynophagia (HP:0032043, a Human Phenotype Ontology term): Pain experienced with swallowing. Evidence: TAS. Frequency: Occasional (HP:0040283, a Human Phenotype Ontology term). (ORPHA:319213)
- Abdominal cramps (HP:0032155, a Human Phenotype Ontology term): A type of abdominal pain characterized by a feeling of contractions and typically fluctuating in intensity. Evidence: TAS. Frequency: Occasional (HP:0040283, a Human Phenotype Ontology term). (ORPHA:319213)
- Periorbital edema (HP:0100539, a Human Phenotype Ontology term): Edema affecting the region situated around the orbit of the eye. Evidence: TAS. Frequency: Occasional (HP:0040283, a Human Phenotype Ontology term). (ORPHA:319213)
- Atelectasis (HP:0100750, a Human Phenotype Ontology term): Collapse of part of a lung associated with absence of inflation (air) of that part. Evidence: TAS. Frequency: Occasional (HP:0040283, a Human Phenotype Ontology term). (ORPHA:319213)
These phenotypes are associated with the disease Lujo hemorrhagic fever (ORPHA:319213, an Orphanet rare-disease identifier).